- Gaze-evoked nystagmus (HP:0000640): Nystagmus made apparent by looking to the right or to the left. Evidence: IEA. (OMIM:606552)
- Diplopia (HP:0000651): Diplopia is a condition in which a single object is perceived as two images, it is also known as double vision. Evidence: TAS. (OMIM:606552)
- Vertigo (HP:0002321): An abnormal sensation of spinning while the body is actually stationary. Evidence: IEA. (OMIM:606552)
- Abnormality of ocular smooth pursuit (HP:0000617): An abnormality of eye movement characterized by impaired smooth-pursuit eye movements. Evidence: IEA. (OMIM:606552)
- Episodic ataxia (HP:0002131): Periodic spells of incoordination and imbalance, that is, episodes of ataxia typically lasting from 10 minutes to several hours or days. Evidence: IEA. (OMIM:606552)
- Esophoria (HP:0025312): A form of strabismus with both eyes turned inward to a relatively mild degree, usually defined as less than 10 prism diopters. Evidence: TAS. (OMIM:606552)
- Tinnitus (HP:0000360): Tinnitus is an auditory perception that can be described as the experience of sound, in the ear or in the head, in the absence of external acoustic stimulation. Evidence: TAS. (OMIM:606552)
- Nausea (HP:0002018): A sensation of unease in the stomach together with an urge to vomit. Evidence: IEA. (OMIM:606552)
- Spasticity (HP:0001257): A motor disorder characterized by a velocity-dependent increase in tonic stretch reflexes with increased muscle tone, exaggerated (hyperexcitable) tendon reflexes. Evidence: IEA. (OMIM:606552)
- Autosomal dominant inheritance (HP:0000006): A mode of inheritance that is observed for traits related to a gene encoded on one of the autosomes (i.e., the human chromosomes 1-22) in which a trait manifests in heterozygotes. In the context of medical genetics, an autosomal dominant disorder is caused when a single copy of the mutant allele is present. Males and females are affected equally, and can both transmit the disorder with a risk of 50% for each child of inheriting the mutant allele. Evidence: IEA. (OMIM:606552)
These phenotypes are associated with the disease episodic ataxia type 4 (OMIM:606552).